- Small for gestational age (HP:0001518): Smaller than normal size according to sex and gestational age related norms, defined as a weight below the 10th percentile for the gestational age. Evidence: TAS. Frequency: Very frequent (HP:0040281). (ORPHA:90051)
- Premature birth (HP:0001622): The birth of a baby of less than 37 weeks of gestational age. Evidence: TAS. Frequency: Very frequent (HP:0040281). (ORPHA:90051)
- Tachycardia (HP:0001649): A rapid heartrate that exceeds the range of the normal resting heartrate for age. Evidence: TAS. Frequency: Very frequent (HP:0040281). (ORPHA:90051)
- Abnormality of immune system physiology (HP:0010978): A functional abnormality of the immune system. Evidence: TAS. Frequency: Very frequent (HP:0040281). (ORPHA:90051)
- Neonatal sepsis (HP:0040187): Systemic inflammatory response to infection in newborn babies. Evidence: TAS. Frequency: Very frequent (HP:0040281). (ORPHA:90051)
- Pallor (HP:0000980): Abnormally pale skin. Evidence: TAS. Frequency: Frequent (HP:0040282). (ORPHA:90051)
- Neonatal hypotonia (HP:0001319): Muscular hypotonia (abnormally low muscle tone) manifesting in the neonatal period. Evidence: TAS. Frequency: Frequent (HP:0040282). (ORPHA:90051)
- Decreased total neutrophil count (HP:0001875): Abnormal decrease of absolute number of neutrophils in the blood, per microlitre, compared to a reference range for a given sex and age-group. Evidence: TAS. Frequency: Frequent (HP:0040282). (ORPHA:90051)
- Metabolic acidosis (HP:0001942): Metabolic acidosis (MA) is characterized by a fall in blood pH due to a reduction of serum bicarbonate concentration. This can occur as a result of either the accumulation of acids (high anion gap MA) or the loss of bicarbonate from the gastrointestinal tract or the kidney (hyperchloremic MA). By definition, MA is not due to a respirary cause. Evidence: TAS. Frequency: Frequent (HP:0040282). (ORPHA:90051)
- Fever (HP:0001945): Body temperature elevated above the normal range. Evidence: TAS. Frequency: Frequent (HP:0040282). (ORPHA:90051)
- Increased total leukocyte count (HP:0001974): An abnormal increase in the number of leukocytes in the blood. Evidence: TAS. Frequency: Frequent (HP:0040282). (ORPHA:90051)
- Hypothermia (HP:0002045): Reduced body temperature due to failed thermoregulation. Evidence: TAS. Frequency: Frequent (HP:0040282). (ORPHA:90051)
- Dyspnea (HP:0002094): Difficult or labored breathing. Dyspnea is a subjective feeling only the patient can rate, e.g., on a Borg scale. Evidence: TAS. Frequency: Frequent (HP:0040282). (ORPHA:90051)
- Gastrointestinal dysmotility (HP:0002579): Abnormal intestinal contractions, such as spasms and intestinal paralysis, related to the loss of the ability of the gut to coordinate muscular activity because of endogenous or exogenous causes. Evidence: TAS. Frequency: Frequent (HP:0040282). (ORPHA:90051)
- Abdominal distention (HP:0003270): Distention of the abdomen. Evidence: TAS. Frequency: Frequent (HP:0040282). (ORPHA:90051)
- Decreased body weight (HP:0004325): Abnormally low body weight. Evidence: TAS. Frequency: Frequent (HP:0040282). (ORPHA:90051)
- Elevated circulating C-reactive protein concentration (HP:0011227): The concentration of C-reactive protein in the blood circulation is above the upper limit of normal. Evidence: TAS. Frequency: Frequent (HP:0040282). (ORPHA:90051)
- Caesarean section (HP:0011410): Delivery of a fetus through surgical incisions made through the abdominal wall (laparotomy) and the uterine wall (hysterotomy). Evidence: TAS. Frequency: Frequent (HP:0040282). (ORPHA:90051)
- Functional abnormality of the gastrointestinal tract (HP:0012719): Abnormal functionality of the gastrointestinal tract. Evidence: TAS. Frequency: Frequent (HP:0040282). (ORPHA:90051)
- Increased circulating interleukin 6 concentration (HP:0030783): The concentration of interleukin-6 in the blood circulation is above the upper limit of normal. Evidence: TAS. Frequency: Frequent (HP:0040282). (ORPHA:90051)
- Abnormal mucociliary clearance (HP:0031602): An anomaly in the system of mucociliary transport, which functions to transport the mucous layer lining the respiratory epithelium by ciliary beating. Evidence: TAS. Frequency: Frequent (HP:0040282). (ORPHA:90051)
- Severe infection (HP:0032169): A type of infection that is regarded as a sign of a pathological susceptibility to infection because of unusual severity or intensity of the infection. Evidence: TAS. Frequency: Frequent (HP:0040282). (ORPHA:90051)
- Abnormal anterior fontanelle morphology (HP:0000236): An abnormality of the anterior fontanelle, i.e., the cranial fontanelle that is located at the intersection of the coronal and sagittal sutures. Evidence: TAS. Frequency: Occasional (HP:0040283). (ORPHA:90051)
- Jaundice (HP:0000952): Yellow pigmentation of the skin due to bilirubin, which in turn is the result of increased bilirubin concentration in the bloodstream. Evidence: TAS. Frequency: Occasional (HP:0040283). (ORPHA:90051)
- Cyanosis (HP:0000961): Bluish discoloration of the skin and mucosa due to poor circulation or inadequate oxygenation of arterial or capillary blood. Evidence: TAS. Frequency: Occasional (HP:0040283). (ORPHA:90051)
- Petechiae (HP:0000967): Petechiae are pinpoint-sized reddish/purple spots, resembling a rash, that appear just under the skin or a mucous membrane when capillaries have ruptured and some superficial bleeding into the skin has happened. This term refers to an abnormally increased susceptibility to developing petechiae. Evidence: TAS. Frequency: Occasional (HP:0040283). (ORPHA:90051)
- Edema (HP:0000969): An abnormal accumulation of fluid beneath the skin, or in one or more cavities of the body. Evidence: TAS. Frequency: Occasional (HP:0040283). (ORPHA:90051)
- Purpura (HP:0000979): Purpura (from Latin: purpura, meaning purple) is the appearance of red or purple discolorations on the skin that do not blanch on applying pressure. They are caused by bleeding underneath the skin. This term refers to an abnormally increased susceptibility to developing purpura. Purpura are larger than petechiae. Evidence: TAS. Frequency: Occasional (HP:0040283). (ORPHA:90051)
- Seizure (HP:0001250): A seizure is an intermittent abnormality of nervous system physiology characterized by a transient occurrence of signs and/or symptoms due to abnormal excessive or synchronous neuronal activity in the brain. Evidence: TAS. Frequency: Occasional (HP:0040283). (ORPHA:90051)
- Hyporeflexia (HP:0001265): Reduction of neurologic reflexes such as the knee-jerk reaction. Evidence: TAS. Frequency: Occasional (HP:0040283). (ORPHA:90051)
- Meningitis (HP:0001287): Inflammation of the meninges. Evidence: TAS. Frequency: Occasional (HP:0040283). (ORPHA:90051)
- Decreased liver function (HP:0001410): Reduced ability of the liver to perform its functions. Evidence: TAS. Frequency: Occasional (HP:0040283). (ORPHA:90051)
- Bradycardia (HP:0001662): A slower than normal heart rate (in adults, slower than 60 beats per minute). Evidence: TAS. Frequency: Occasional (HP:0040283). (ORPHA:90051)
- Splenomegaly (HP:0001744): Abnormal increased size of the spleen. Evidence: TAS. Frequency: Occasional (HP:0040283). (ORPHA:90051)
- Thrombocytopenia (HP:0001873): A reduction in the number of circulating thrombocytes. Evidence: TAS. Frequency: Occasional (HP:0040283). (ORPHA:90051)
- Abnormal bleeding (HP:0001892): An abnormal susceptibility to bleeding, often referred to as a bleeding diathesis. A bleeding diathesis may be related to vascular, platelet and coagulation defects. Evidence: TAS. Frequency: Occasional (HP:0040283). (ORPHA:90051)
- Anemia (HP:0001903): A reduction in erythrocytes volume or hemoglobin concentration. Evidence: TAS. Frequency: Occasional (HP:0040283). (ORPHA:90051)
- Vomiting (HP:0002013): Forceful ejection of the contents of the stomach through the mouth by means of a series of involuntary spasmic contractions. Evidence: TAS. Frequency: Occasional (HP:0040283). (ORPHA:90051)
- Diarrhea (HP:0002014): Abnormally increased frequency (usually defined as three or more) loose or watery bowel movements a day. Evidence: TAS. Frequency: Occasional (HP:0040283). (ORPHA:90051)
- Hepatomegaly (HP:0002240): Abnormally increased size of the liver. Evidence: TAS. Frequency: Occasional (HP:0040283). (ORPHA:90051)
- Hypotension (HP:0002615): Low Blood Pressure, vascular hypotension. Evidence: TAS. Frequency: Occasional (HP:0040283). (ORPHA:90051)
- Pregnancy history (HP:0002686): Medical history of maternal diseases, exposures, or other relevant findings during the pregnancy of which the index person was the product. Evidence: TAS. Frequency: Occasional (HP:0040283). (ORPHA:90051)
- Abnormal respiratory system physiology (HP:0002795): Abnormal function of the respiratory system. Evidence: TAS. Frequency: Occasional (HP:0040283). (ORPHA:90051)
- Enterocolitis (HP:0004387): An inflammation of the colon and small intestine. However, most conditions are either categorized as Enteritis (inflammation of the small intestine) or Colitis (inflammation of the large intestine). Evidence: TAS. Frequency: Occasional (HP:0040283). (ORPHA:90051)
- Reversible renal failure (HP:0004713): Acute renal failure with resolution of manifestations. Evidence: TAS. Frequency: Occasional (HP:0040283). (ORPHA:90051)
- Temperature instability (HP:0005968): Disordered thermoregulation characterized by an impaired ability to maintain a balance between heat production and heat loss, with resulting instability of body temperature. Evidence: TAS. Frequency: Occasional (HP:0040283). (ORPHA:90051)
- Nasal flaring (HP:0030863): Widening of the nostrils upon inhalation as a manifestation of respiratory distress. Evidence: TAS. Frequency: Occasional (HP:0040283). (ORPHA:90051)
- Oliguria (HP:0100520): Low output of urine, clinically classified as an output below 300-500ml/day. Evidence: TAS. Frequency: Occasional (HP:0040283). (ORPHA:90051)
- Acute disseminated intravascular coagulation (HP:0011880): An acute form of disseminated intravascular coagulation. Acute DIC can occur following sudden exposure of blood to procoagulants, with the compensatory hemostatic mechanisms becoming overwhelmed. Evidence: TAS. Frequency: Very rare (HP:0040284). (ORPHA:90051)
- Invasive fungal infection (HP:0020101): Fungal infection characterized by invasion of host tissues. Evidence: TAS. Frequency: Very rare (HP:0040284). (ORPHA:90051)
- Disseminated viral infection (HP:0031696): A viral infection that fails to be contained by the immune system and spreads throughout the body. Evidence: TAS. Frequency: Very rare (HP:0040284). (ORPHA:90051)
These phenotypes are associated with the disease Sepsis in premature infants (ORPHA:90051).